- Gait disturbance (HP:0001288): The term gait disturbance can refer to any disruption of the ability to walk. Evidence: TAS. Frequency: Frequent (HP:0040282). (ORPHA:97335)
- Knee pain (HP:0030839): An unpleasant sensation characterized by physical discomfort (such as pricking, throbbing, or aching) localized to the knee. Evidence: TAS. Frequency: Very frequent (HP:0040281). (ORPHA:97335)
- Abnormal patella morphology (HP:0003045): Abnormality of the patella (knee cap). Evidence: TAS. Frequency: Frequent (HP:0040282). (ORPHA:97335)
- Limited knee extension (HP:0003066): Reduced ability to extend (straighten) the knee joint. Evidence: TAS. Frequency: Frequent (HP:0040282). (ORPHA:97335)
- Irregular proximal tibial epiphyses (HP:0006456): Anomaly of the contour of the proximal epiphysis of the tibia such that its normally smooth appearance is irregular. Evidence: TAS. Frequency: Frequent (HP:0040282). (ORPHA:97335)
- Difficulty running (HP:0009046): Reduced ability to run. Evidence: TAS. Frequency: Frequent (HP:0040282). (ORPHA:97335)
- Shuffling gait (HP:0002362): A type of gait (walking) characterized by by dragging one's feet along or without lifting the feet fully from the ground. Evidence: TAS. Frequency: Occasional (HP:0040283). (ORPHA:97335)
- Large knee (HP:0030866): Abnormally increased size of the knee joint. Evidence: TAS. Frequency: Occasional (HP:0040283). (ORPHA:97335)
These phenotypes are associated with the disease Osgood-Schlatter disease (ORPHA:97335).